- Hyperkeratosis (HP:0000962): Hyperkeratosis is a histopathological term defining a thickened stratum corneum and may be present in many different skin conditions, with many possible overlaps. Hyperkeratosis refers to the increased thickness of the stratum corneum, the outer layer of the skin. Hyperkeratosis is subclassified as orthokeratotic or parakeratotic. Orthokeratotic hyperkeratosis refers to the thickening of the keratin layer with preserved keratinocyte maturation, while parakeratotic hyperkeratosis shows retained nuclei as a sign of delayed maturation of keratinocytes. Evidence: TAS. Frequency: Very frequent (HP:0040281). (ORPHA:312)
- Erythroderma (HP:0001019): An inflammatory exfoliative dermatosis involving nearly all of the surface of the skin. Erythroderma develops suddenly. A patchy erythema may generalize and spread to affect most of the skin. Scaling may appear in 2-6 days and be accompanied by hot, red, dry skin, malaise, and fever. Evidence: TAS. Frequency: Very frequent (HP:0040281). (ORPHA:312)
- Weight loss (HP:0001824): Reduction of total body weight. Evidence: TAS. Frequency: Very frequent (HP:0040281). (ORPHA:312)
- Poor appetite (HP:0004396): A reduced desire to eat. Evidence: TAS. Frequency: Very frequent (HP:0040281). (ORPHA:312)
- Congenital bullous ichthyosiform erythroderma (HP:0007475): An ichthyosiform abnormality of the skin that presents at birth or shortly thereafter with generalized erythema, blistering, erosions, and peeling. In the subsequent months, erythema and blistering improves but patients go on to develop hyperkeratotic scaling that is especially prominent along the joint flexures, neck, hands and feet. Evidence: TAS. Frequency: Very frequent (HP:0040281). (ORPHA:312)
- Ichthyosis (HP:0008064): An abnormality of the skin characterized the presence of excessive amounts of dry surface scales on the skin resulting from an abnormality of keratinization. Evidence: TAS. Frequency: Very frequent (HP:0040281). (ORPHA:312)
- Abnormal blistering of the skin (HP:0008066): The presence of one or more bullae on the skin, defined as fluid-filled blisters more than 5 mm in diameter with thin walls. Evidence: TAS. Frequency: Very frequent (HP:0040281). (ORPHA:312)
- Cutaneous photosensitivity (HP:0000992): An increased sensitivity of the skin to light. Photosensitivity may result in a rash upon exposure to the sun (which is known as photodermatosis). Photosensitivity can be diagnosed by phototests in which light is shone on small areas of skin. Evidence: TAS. Frequency: Frequent (HP:0040282). (ORPHA:312)
- Palmoplantar keratoderma (HP:0000982): Abnormal thickening of the skin of the palms of the hands and the soles of the feet. Evidence: TAS. Frequency: Occasional (HP:0040283). (ORPHA:312)
- Conjunctival hamartoma (HP:0100780): A hamartoma (disordered proliferation of mature tissues) of the conjunctiva. Evidence: TAS. Frequency: Occasional (HP:0040283). (ORPHA:312)
- Skin ulcer (HP:0200042): A discontinuity of the skin exhibiting complete loss of the epidermis and often portions of the dermis and even subcutaneous fat. Evidence: TAS. Frequency: Occasional (HP:0040283). (ORPHA:312)
These phenotypes are associated with the disease Autosomal dominant epidermolytic ichthyosis (ORPHA:312).